- Congenital onset (HP:0003577): A phenotypic abnormality that is present at birth. Evidence: PCS. Frequency: 2/2. (PMID:30425301)
- Sparse body hair (HP:0002231): Sparseness of the body hair. Evidence: PCS. Frequency: 2/2. (PMID:30425301)
- Sparse hair (HP:0008070): Reduced density of hairs. Evidence: PCS. Frequency: 3/3. (PMID:30425301)
- Dry skin (HP:0000958): Skin characterized by the lack of natural or normal moisture. Evidence: PCS. Frequency: 2/2. Onset: Congenital onset (HP:0003577). (PMID:30425301)
- Photophobia (HP:0000613): Excessive sensitivity to light with the sensation of discomfort or pain in the eyes due to exposure to bright light. Evidence: PCS. Frequency: 2/2. Onset: Congenital onset (HP:0003577). (PMID:30425301)
- Sparse scalp hair (HP:0002209): Decreased number of hairs per unit area of skin of the scalp. Evidence: PCS. Frequency: 2/2. Onset: Childhood onset (HP:0011463). (PMID:30425301)
- Autosomal recessive inheritance (HP:0000007): A mode of inheritance that is observed for traits related to a gene encoded on one of the autosomes (i.e., the human chromosomes 1-22) in which a trait manifests in individuals with two pathogenic alleles, either homozygotes (two copies of the same mutant allele) or compound heterozygotes (whereby each copy of a gene has a distinct mutant allele). Evidence: PCS. (PMID:30425301)
- Eczematoid dermatitis (HP:0000964): Eczema is a form of dermatitis that is characterized by scaly, pruritic, erythematous lesions located on flexural surfaces. Evidence: PCS. Frequency: 2/2. (PMID:30425301)
- Pruritus (HP:0000989): Pruritus is an itch or a sensation that makes a person want to scratch. This term refers to an abnormally increased disposition to experience pruritus. Evidence: PCS. Frequency: 1/2. (PMID:30425301)
- Hypohidrosis (HP:0000966): Abnormally diminished capacity to sweat. Evidence: PCS. Frequency: 2/2. (PMID:30425301)
- Sparse eyelashes (HP:0000653): Decreased density/number of eyelashes. Evidence: PCS. Frequency: 2/2. (PMID:30425301)
- Blepharitis (HP:0000498): Inflammation of the eyelids. Evidence: PCS. Frequency: 2/2. Onset: Congenital onset (HP:0003577). (PMID:30425301)
- Slow-growing hair (HP:0002217): Hair whose growth is slower than normal. Evidence: PCS. Frequency: 2/2. (PMID:30425301)
- Palmoplantar keratoderma (HP:0000982): Abnormal thickening of the skin of the palms of the hands and the soles of the feet. Evidence: PCS. Frequency: 0/2. (PMID:30425301)
These phenotypes are associated with the disease ectodermal dysplasia 15, hypohidrotic/hair type (OMIM:618535).